Phenotypes associated with the disease Mesomelic dwarfism-cleft palate-camptodactyly syndrome (ORPHA:2631):
- Cleft palate (HP:0000175): Cleft palate is a developmental defect of the palate resulting from a failure of fusion of the palatine processes and manifesting as a separation of the roof of the mouth (soft and hard palate). Evidence: TAS. Frequency: Very frequent (HP:0040281). (ORPHA:2631)
- Retrognathia (HP:0000278): An abnormality in which the mandible is mislocalised posteriorly. Evidence: TAS. Frequency: Very frequent (HP:0040281). (ORPHA:2631)
- Mesomelia (HP:0003027): Shortening of the middle parts of the limbs (forearm and lower leg) in relation to the upper and terminal segments. Evidence: TAS. Frequency: Very frequent (HP:0040281). (ORPHA:2631)
- Elbow dislocation (HP:0003042): Dislocation of the distal humerus out of the elbow joint, where the radius, ulna, and humerus meet. Evidence: TAS. Frequency: Very frequent (HP:0040281). (ORPHA:2631)
- Abnormal hip bone morphology (HP:0003272): An abnormality of the hip bone. Evidence: TAS. Frequency: Very frequent (HP:0040281). (ORPHA:2631)
- Bowing of the long bones (HP:0006487): A bending or abnormal curvature of a long bone. Evidence: TAS. Frequency: Very frequent (HP:0040281). (ORPHA:2631)
- Skin dimple (HP:0010781): Skin dimples are cutaneous indentations that are the result of tethering of the skin to underlying structures (bone) causing an indentation. Evidence: TAS. Frequency: Very frequent (HP:0040281). (ORPHA:2631)
- Camptodactyly of finger (HP:0100490): The distal interphalangeal joint and/or the proximal interphalangeal joint of the fingers cannot be extended to 180 degrees by either active or passive extension. Evidence: TAS. Frequency: Very frequent (HP:0040281). (ORPHA:2631)
- Thin vermilion border (HP:0000233): Height of the vermilion of the medial part of the lip more than 2 SD below the mean, or apparently reduced height of the vermilion of the lip in the frontal view. The vermilion is the red part of the lips (and confusingly, the vermilion itself is also often referred to as being equivalent the lips). Evidence: TAS. Frequency: Frequent (HP:0040282). (ORPHA:2631)
- Overfolded helix (HP:0000396): A condition in which the helix is folded over to a greater degree than normal. That is, excessive curling of the helix edge, whereby the free edge is parallel to the plane of the ear. Evidence: TAS. Frequency: Frequent (HP:0040282). (ORPHA:2631)
- Abnormal metaphysis morphology (HP:0000944): An abnormality of one or more metaphysis, i.e., of the somewhat wider portion of a long bone that is adjacent to the epiphyseal growth plate and grows during childhood. Evidence: TAS. Frequency: Frequent (HP:0040282). (ORPHA:2631)
- Pulmonary hypoplasia (HP:0002089). Evidence: TAS. Frequency: Frequent (HP:0040282). (ORPHA:2631)
- Abnormal lung lobation (HP:0002101): A developmental defect in the formation of pulmonary lobes. Evidence: TAS. Frequency: Frequent (HP:0040282). (ORPHA:2631)
- Vertebral segmentation defect (HP:0003422): An abnormality related to a defect of vertebral separation during development. Evidence: TAS. Frequency: Frequent (HP:0040282). (ORPHA:2631)
- Abnormal metacarpal morphology (HP:0005916): Any abnormal shape or structure of the metacarpal bones. Evidence: TAS. Frequency: Frequent (HP:0040282). (ORPHA:2631)
- Abnormal epiphysis morphology (HP:0005930): An anomaly of epiphysis, which is the expanded articular end of a long bone that developes from a secondary ossification center, and which during the period of growth is either entirely cartilaginous or is separated from the shaft by a cartilaginous disk. Evidence: TAS. Frequency: Frequent (HP:0040282). (ORPHA:2631)
- Posteriorly rotated ears (HP:0000358): A type of abnormal location of the ears in which the position of the ears is characterized by posterior rotation (the superior part of the ears is rotated towards the back of the head, and the inferior part of the ears towards the front). Evidence: TAS. Frequency: Frequent (HP:0040282). (ORPHA:2631)